- Constriction of peripheral visual field (HP:0001133): An absolute or relative decrease in retinal sensitivity extending from edge (periphery) of the visual field in a concentric pattern. The visual field is the area that is perceived simultaneously by a fixating eye. Evidence: PCS. Frequency: 14/16. (PMID:28549094)
- Spicular pigmentation of the retina (HP:0007737): Pigment migration into the retina in a bone-spicule configuration (resembling the nucleated cells within the lacuna of bone). Evidence: PCS. Frequency: 1/1. (PMID:28549094)
- Reduced visual acuity (HP:0007663). Evidence: PCS. Frequency: 17/18. (PMID:28549094)
- Rod-cone dystrophy (HP:0000510): An inherited retinal disease subtype in which the rod photoreceptors appear to be more severely affected than the cone photoreceptors. Typical presentation is with nyctalopia (due to rod dysfunction) followed by loss of mid-peripheral field of vision, which gradually extends and leaves many patients with a small central island of vision due to the preservation of macular cones. Evidence: PCS. Frequency: 18/18. (PMID:28549094)
- Retinal thinning on OCT (HP:0030329): Reduced anteroposterior thickness of the retina. This phenotype can be appreciated by retinal optical coherence tomography (OCT). Evidence: PCS. Frequency: 1/1. (PMID:28549094)
- Autosomal dominant inheritance (HP:0000006): A mode of inheritance that is observed for traits related to a gene encoded on one of the autosomes (i.e., the human chromosomes 1-22) in which a trait manifests in heterozygotes. In the context of medical genetics, an autosomal dominant disorder is caused when a single copy of the mutant allele is present. Males and females are affected equally, and can both transmit the disorder with a risk of 50% for each child of inheriting the mutant allele. Evidence: PCS. (PMID:28549094)
These phenotypes are associated with the disease retinitis pigmentosa 96 (OMIM:620228).